Phenotypes associated with the disease DEFECTIVE INTERFERING PARTICLE INDUCTION, CONTROL OF (OMIM:125260):
- Abnormality of the immune system (HP:0002715): An abnormality of the immune system. Evidence: IEA. (OMIM:125260)
- Autosomal dominant inheritance (HP:0000006): A mode of inheritance that is observed for traits related to a gene encoded on one of the autosomes (i.e., the human chromosomes 1-22) in which a trait manifests in heterozygotes. In the context of medical genetics, an autosomal dominant disorder is caused when a single copy of the mutant allele is present. Males and females are affected equally, and can both transmit the disorder with a risk of 50% for each child of inheriting the mutant allele. Evidence: IEA. (OMIM:125260)